Phenotypes associated with the disease mitochondrial complex I deficiency, nuclear type 11 (OMIM:618234):
- Encephalopathy (HP:0001298): Encephalopathy is a term that means brain disease, damage, or malfunction. In general, encephalopathy is manifested by an altered mental state. Evidence: IEA. (OMIM:618234)
- Scoliosis (HP:0002650): The presence of an abnormal lateral curvature of the spine. Evidence: IEA. (OMIM:618234)
- Moderate intellectual disability (HP:0002342): Moderate intellectual disability (ID) is defined as a type of ID characterized by moderately sub-average adaptive functioning and intellectual functioning, with an intelligence quotient (IQ) the range of 35-49. Evidence: PCS. Frequency: 1/1. (PMID:17557076)
- Myopathy (HP:0003198): A disorder of muscle unrelated to impairment of innervation or neuromuscular junction. Evidence: IEA. (OMIM:618234)
- Global developmental delay (HP:0001263): A delay in the achievement of motor or mental milestones in the domains of development of a child, including motor skills, speech and language, cognitive skills, and social and emotional skills. This term should only be used to describe children younger than five years of age. Evidence: PCS. Frequency: 1/1. (PMID:17557076)
- Increased circulating lactate concentration (HP:0002151): Abnormally increased level of blood lactate (2-hydroxypropanoic acid). Lactate is produced from pyruvate by lactate dehydrogenase during normal metabolism. The terms lactate and lactic acid are often used interchangeably but lactate (the component measured in blood) is strictly a weak base whereas lactic acid is the corresponding acid. Lactic acidosis is often used clinically to describe elevated lactate but should be reserved for cases where there is a corresponding acidosis (pH below 7.35). Evidence: IEA. (OMIM:618234)
- Hypotonia (HP:0001252): Hypotonia is an abnormally low muscle tone (the amount of tension or resistance to movement in a muscle). Even when relaxed, muscles have a continuous and passive partial contraction which provides some resistance to passive stretching. Hypotonia thus manifests as diminished resistance to passive stretching. Hypotonia is not the same as muscle weakness, although the two conditions can co-exist. Evidence: PCS. Frequency: 1/1. (PMID:17557076)
- Hepatomegaly (HP:0002240): Abnormally increased size of the liver. Evidence: IEA. (OMIM:618234)
- Infantile onset (HP:0003593): Onset of signs or symptoms of disease between 28 days to one year of life. Evidence: PCS. Frequency: 1/1. (PMID:17557076)
- Pigmentary retinopathy (HP:0000580): An abnormality of the retina characterized by pigment deposition. It is typically associated with migration and proliferation of macrophages or retinal pigment epithelial cells into the retina; melanin from these cells causes the pigmentary changes. Pigmentary retinopathy is a common final pathway of many retinal conditions and is often associated with visual loss. Evidence: PCS. Frequency: 1/1. (PMID:17557076)
- Decreased activity of mitochondrial complex I (HP:0011923): A reduction in the activity of the mitochondrial respiratory chain complex I, which is part of the electron transport chain in mitochondria. Evidence: PCS. Frequency: 1/1. (PMID:17557076)
- Osteoporosis (HP:0000939): Osteoporosis is a systemic skeletal disease characterized by low bone density and microarchitectural deterioration of bone tissue with a consequent increase in bone fragility. According to the WHO criteria, osteoporosis is defined as a BMD that lies 2.5 standard deviations or more below the average value for young healthy adults (a T-score below -2.5 SD). Evidence: IEA. (OMIM:618234)
- Failure to thrive (HP:0001508): Failure to thrive (FTT) refers to a child whose physical growth is substantially below the norm. Evidence: PCS. Frequency: 1/1. (PMID:17557076)
- Hypertrophic cardiomyopathy (HP:0001639): Hypertrophic cardiomyopathy (HCM) is defined by the presence of increased ventricular wall thickness or mass in the absence of loading conditions (hypertension, valve disease) sufficient to cause the observed abnormality. Evidence: PCS. Frequency: 1/1. (PMID:17557076)
- Kyphosis (HP:0002808): Exaggerated anterior convexity of the thoracic vertebral column. Evidence: IEA. (OMIM:618234)
- Cerebral visual impairment (HP:0100704): A form of loss of vision caused by damage to the visual cortex rather than a defect in the eye. Evidence: PCS. Frequency: 1/1. (PMID:17557076)
- Wolff-Parkinson-White syndrome (HP:0001716): A disorder of the cardiac conduction system of the heart characterized by ventricular preexcitation due to the presence of an abnormal accessory atrioventricular electrical conduction pathway. Evidence: PCS. Frequency: 1/1. (PMID:17557076)
- Autosomal recessive inheritance (HP:0000007): A mode of inheritance that is observed for traits related to a gene encoded on one of the autosomes (i.e., the human chromosomes 1-22) in which a trait manifests in individuals with two pathogenic alleles, either homozygotes (two copies of the same mutant allele) or compound heterozygotes (whereby each copy of a gene has a distinct mutant allele). Evidence: PCS. (PMID:17557076)
- Congestive heart failure (HP:0001635): The presence of an abnormality of cardiac function that is responsible for the failure of the heart to pump blood at a rate that is commensurate with the needs of the tissues or a state in which abnormally elevated filling pressures are required for the heart to do so. Heart failure is frequently related to a defect in myocardial contraction. Evidence: PCS. Frequency: 1/1. (PMID:17557076)
- Macrovesicular hepatic steatosis (HP:0001403): A form of hepatic steatosis characterized by the presence of large, lipid-laden vesicles in the affected hepatocytes. Evidence: IEA. (OMIM:618234)
- Metabolic acidosis (HP:0001942): Metabolic acidosis (MA) is characterized by a fall in blood pH due to a reduction of serum bicarbonate concentration. This can occur as a result of either the accumulation of acids (high anion gap MA) or the loss of bicarbonate from the gastrointestinal tract or the kidney (hyperchloremic MA). By definition, MA is not due to a respirary cause. Evidence: IEA. (OMIM:618234)
- Lactic acidosis (HP:0003128): An abnormal buildup of lactic acid in the body, leading to acidification of the blood and other bodily fluids. Evidence: PCS. Frequency: 1/1. (PMID:17557076)